Phenotypes associated with the disease lithium transport (OMIM:152420):
- Bipolar affective disorder (HP:0007302): Bipolar disorder is an illness of mood characterized by alternating episodes of elevated and depressed moods, which are interspersed with euthymic periods. Evidence: TAS. (OMIM:152420)
- Autosomal dominant inheritance (HP:0000006): A mode of inheritance that is observed for traits related to a gene encoded on one of the autosomes (i.e., the human chromosomes 1-22) in which a trait manifests in heterozygotes. In the context of medical genetics, an autosomal dominant disorder is caused when a single copy of the mutant allele is present. Males and females are affected equally, and can both transmit the disorder with a risk of 50% for each child of inheriting the mutant allele. Evidence: IEA. (OMIM:152420)